Phenotypes associated with the disease dystonia 37, early-onset, with striatal lesions (OMIM:620427):
- Dysphagia (HP:0002015): Difficulty in swallowing. Evidence: PCS. Frequency: 3/3. (PMID:36333996)
- Microcephaly (HP:0000252): Head circumference below 2 standard deviations below the mean for age and gender. Evidence: PCS. Frequency: 1/3. (PMID:36333996)
- Juvenile onset (HP:0003621): Onset of signs or symptoms of disease between the age of 5 and 15 years. Evidence: PCS. Frequency: 1/3. (PMID:36333996)
- Choreoathetosis (HP:0001266): Involuntary movements characterized by both athetosis (inability to sustain muscles in a fixed position) and chorea (widespread jerky arrhythmic movements). Evidence: PCS. Frequency: 1/3. (PMID:36333996)
- Leg dystonia (HP:0031959): A type of dystonia (abnormally increased muscular tone causing fixed abnormal postures) that affects muscles of the legs. Evidence: PCS. Frequency: 1/3. (PMID:36333996)
- Dysarthria (HP:0001260): Dysarthric speech is a general description referring to a neurological speech disorder characterized by poor articulation. Depending on the involved neurological structures, dysarthria may be further classified as spastic, flaccid, ataxic, hyperkinetic and hypokinetic, or mixed. Evidence: PCS. Frequency: 3/3. (PMID:36333996)
- Hypotonia (HP:0001252): Hypotonia is an abnormally low muscle tone (the amount of tension or resistance to movement in a muscle). Even when relaxed, muscles have a continuous and passive partial contraction which provides some resistance to passive stretching. Hypotonia thus manifests as diminished resistance to passive stretching. Hypotonia is not the same as muscle weakness, although the two conditions can co-exist. Evidence: PCS. Frequency: 2/3. (PMID:36333996)
- Ataxia (HP:0001251): Ataxia refers to impaired coordination of voluntary muscle movement. Cerebellar ataxia refers to ataxia due to dysfunction of the cerebellum. This causes a variety of elementary neurological deficits including asynergy (lack of coordination between muscles, limbs and joints), dysmetria (lack of ability to judge distances that can lead to under- or overshoot in grasping movements), and dysdiadochokinesia (inability to perform rapid movements requiring antagonizing muscle groups to be switched on and off repeatedly). Evidence: PCS. Frequency: 3/3. (PMID:36333996)
- Chorea (HP:0002072): Chorea (Greek for 'dance') refers to widespread arrhythmic involuntary movements of a forcible, jerky and restless fashion. It is a random-appearing sequence of one or more discrete involuntary movements or movement fragments. Movements appear random because of variability in timing, duration or location. Each movement may have a distinct start and end. However, movements may be strung together and thus may appear to flow randomly from one muscle group to another. Chorea can involve the trunk, neck, face, tongue, and extremities. Evidence: PCS. Frequency: 1/1. (PMID:36333996)
- Motor delay (HP:0001270): A type of Developmental delay characterized by a delay in acquiring motor skills. Evidence: PCS. Frequency: 3/3. (PMID:36333996)
- Sleep apnea (HP:0010535): An intermittent cessation of airflow at the mouth and nose during sleep is known as sleep apnea. Apneas that last at least 10 seconds are considered significant, but individuals with sleep apnea may experience apneas lasting from 20 seconds up to 2 or 3 minutes. Patients may have up to 15 events per hour of sleep. Evidence: PCS. Frequency: 1/3. (PMID:36333996)
- Childhood onset (HP:0011463): Onset of disease at the age of between 1 and 5 years. Evidence: PCS. Frequency: 2/3. (PMID:36333996)
- Oculomotor apraxia (HP:0000657): Ocular motor apraxia is a deficiency in voluntary, horizontal, lateral, fast eye movements (saccades) with retention of slow pursuit movements. The inability to follow objects visually is often compensated by head movements. There may be decreased smooth pursuit, and cancelation of the vestibulo-ocular reflex. Evidence: PCS. Frequency: 1/3. (PMID:36333996)
- Autosomal recessive inheritance (HP:0000007): A mode of inheritance that is observed for traits related to a gene encoded on one of the autosomes (i.e., the human chromosomes 1-22) in which a trait manifests in individuals with two pathogenic alleles, either homozygotes (two copies of the same mutant allele) or compound heterozygotes (whereby each copy of a gene has a distinct mutant allele). Evidence: PCS. (PMID:36333996)
- Loss of ambulation (HP:0002505): Inability to walk in a person who previous had the ability to walk. Evidence: PCS. Frequency: 3/3. (PMID:36333996)
- Generalized dystonia (HP:0007325): A type of dystonia that affects all or most of the body. Evidence: PCS. Frequency: 2/3. (PMID:36333996)
- Intellectual disability (HP:0001249): The term intellectual disability or intellectual developmental disorder is used to describe significantly sub-average intellectual and adaptive functioning based on clinical assessment and as measured by individually administered, appropriately normed, standardized and validated tests of intellectual functioning and adaptive behavior, with onset during the developmental period from infancy through adolescence. Evidence: PCS. Frequency: 1/3. (PMID:36333996)